- Increased cellular sensitivity to UV light (HP:0003224). Evidence: TAS. (OMIM:614640)
- Cutaneous photosensitivity (HP:0000992): An increased sensitivity of the skin to light. Photosensitivity may result in a rash upon exposure to the sun (which is known as photodermatosis). Photosensitivity can be diagnosed by phototests in which light is shone on small areas of skin. Evidence: TAS. (OMIM:614640)
- Dry skin (HP:0000958): Skin characterized by the lack of natural or normal moisture. Evidence: TAS. (OMIM:614640)
- Freckling (HP:0001480): The presence of an increased number of freckles, small circular spots on the skin that are darker than the surrounding skin because of deposits of melanin. Evidence: TAS. (OMIM:614640)
- Infantile onset (HP:0003593): Onset of signs or symptoms of disease between 28 days to one year of life. Evidence: TAS. (OMIM:614640)
- Telangiectasia (HP:0001009): Telangiectasias refer to small dilated blood vessels located near the surface of the skin or mucous membranes, measuring between 0.5 and 1 millimeter in diameter. Telangiectasia are located especially on the tongue, lips, palate, fingers, face, conjunctiva, trunk, nail beds, and fingertips. Evidence: TAS. (OMIM:614640)
- Autosomal recessive inheritance (HP:0000007): A mode of inheritance that is observed for traits related to a gene encoded on one of the autosomes (i.e., the human chromosomes 1-22) in which a trait manifests in individuals with two pathogenic alleles, either homozygotes (two copies of the same mutant allele) or compound heterozygotes (whereby each copy of a gene has a distinct mutant allele). Evidence: PCS. (PMID:22466610)
These phenotypes are associated with the disease UV-sensitive syndrome 3 (OMIM:614640).